Phenotypes associated with the disease Neuroleptic malignant syndrome (ORPHA:94093):
- Hyperhidrosis (HP:0000975): Abnormal excessive perspiration (sweating) despite the lack of appropriate stimuli like hot and humid weather. Evidence: TAS. Frequency: Very frequent (HP:0040281). (ORPHA:94093)
- Fever (HP:0001945): Body temperature elevated above the normal range. Evidence: TAS. Frequency: Very frequent (HP:0040281). (ORPHA:94093)
- Mutism (HP:0002300): Complete lack of speech or verbal communication in a person despite attempts to engage in conversation. Mutism as a phenomena assumes the individual has previous capacity for speech and in the pediatric population it assumes that the person is past the age of typical language development. Evidence: TAS. Frequency: Very frequent (HP:0040281). (ORPHA:94093)
- Reduced consciousness (HP:0004372): Abnormally diminished level of attention, responsiveness, or wakefulness. Evidence: TAS. Frequency: Very frequent (HP:0040281). (ORPHA:94093)
- Extrapyramidal muscular rigidity (HP:0007076): Muscular rigidity (continuous contraction of muscles with constant resistance to passive movement). Evidence: TAS. Frequency: Very frequent (HP:0040281). (ORPHA:94093)
- Abnormal autonomic nervous system physiology (HP:0012332): A functional abnormality of the autonomic nervous system. Evidence: TAS. Frequency: Very frequent (HP:0040281). (ORPHA:94093)
- Hypertension (HP:0000822): The presence of chronic increased pressure in the systemic arterial system. Evidence: TAS. Frequency: Frequent (HP:0040282). (ORPHA:94093)
- Tremor (HP:0001337): An unintentional, oscillating to-and-fro muscle movement about a joint axis. Evidence: TAS. Frequency: Frequent (HP:0040282). (ORPHA:94093)
- Tachycardia (HP:0001649): A rapid heartrate that exceeds the range of the normal resting heartrate for age. Evidence: TAS. Frequency: Frequent (HP:0040282). (ORPHA:94093)
- Metabolic acidosis (HP:0001942): Metabolic acidosis (MA) is characterized by a fall in blood pH due to a reduction of serum bicarbonate concentration. This can occur as a result of either the accumulation of acids (high anion gap MA) or the loss of bicarbonate from the gastrointestinal tract or the kidney (hyperchloremic MA). By definition, MA is not due to a respirary cause. Evidence: TAS. Frequency: Frequent (HP:0040282). (ORPHA:94093)
- Increased total leukocyte count (HP:0001974): An abnormal increase in the number of leukocytes in the blood. Evidence: TAS. Frequency: Frequent (HP:0040282). (ORPHA:94093)
- Dysphagia (HP:0002015): Difficulty in swallowing. Evidence: TAS. Frequency: Frequent (HP:0040282). (ORPHA:94093)
- Drooling (HP:0002307): Habitual flow of saliva out of the mouth. Evidence: TAS. Frequency: Frequent (HP:0040282). (ORPHA:94093)
- Elevated circulating creatine kinase activity (HP:0003236): The activity of creatine kinase in the blood circulation is above the upper limit of normal. Evidence: TAS. Frequency: Frequent (HP:0040282). (ORPHA:94093)
- Muscle spasm (HP:0003394): Sudden and involuntary contractions of one or more muscles. Evidence: TAS. Frequency: Frequent (HP:0040282). (ORPHA:94093)
- Excessive salivation (HP:0003781): Excessive production of saliva. Evidence: TAS. Frequency: Frequent (HP:0040282). (ORPHA:94093)
- Fatigue (HP:0012378): A subjective feeling of tiredness characterized by a lack of energy and motivation. Evidence: TAS. Frequency: Frequent (HP:0040282). (ORPHA:94093)
- Urinary incontinence (HP:0000020): Loss of the ability to control the urinary bladder leading to involuntary urination. Evidence: TAS. Frequency: Occasional (HP:0040283). (ORPHA:94093)
- Proteinuria (HP:0000093): Increased levels of protein in the urine. Evidence: TAS. Frequency: Occasional (HP:0040283). (ORPHA:94093)
- Agitation (HP:0000713): A state of excessive motor activity that is associated with mental distress or a feeling of substantial unease or inner tension. Distinguished from restlessness by the increased level of emotional distress and negative intensity of the experience. Agitation has a significant level of physical activity that is typically threatening to the self or others. Evidence: TAS. Frequency: Occasional (HP:0040283). (ORPHA:94093)
- Anxiety (HP:0000739): Intense feelings of nervousness, tension, or panic often arise in response to interpersonal stresses. There is worry about the negative effects of past unpleasant experiences and future negative possibilities. Individuals may feel fearful, apprehensive, or threatened by uncertainty, and they may also have fears of falling apart or losing control. Evidence: TAS. Frequency: Occasional (HP:0040283). (ORPHA:94093)
- Coma (HP:0001259): The complete absence of wakefulness and consciousness, which is evident through a lack of response to any form of external stimuli. Evidence: TAS. Frequency: Occasional (HP:0040283). (ORPHA:94093)
- Encephalopathy (HP:0001298): Encephalopathy is a term that means brain disease, damage, or malfunction. In general, encephalopathy is manifested by an altered mental state. Evidence: TAS. Frequency: Occasional (HP:0040283). (ORPHA:94093)
- Thrombocytosis (HP:0001894): Increased numbers of platelets in the peripheral blood. Evidence: TAS. Frequency: Occasional (HP:0040283). (ORPHA:94093)
- Acute kidney injury (HP:0001919): Sudden loss of renal function, as manifested by decreased urine production, and a rise in serum creatinine or blood urea nitrogen concentration (azotemia). Evidence: TAS. Frequency: Occasional (HP:0040283). (ORPHA:94093)
- Dehydration (HP:0001944). Evidence: TAS. Frequency: Occasional (HP:0040283). (ORPHA:94093)
- Vomiting (HP:0002013): Forceful ejection of the contents of the stomach through the mouth by means of a series of involuntary spasmic contractions. Evidence: TAS. Frequency: Occasional (HP:0040283). (ORPHA:94093)
- Nausea (HP:0002018): A sensation of unease in the stomach together with an urge to vomit. Evidence: TAS. Frequency: Occasional (HP:0040283). (ORPHA:94093)
- Chorea (HP:0002072): Chorea (Greek for 'dance') refers to widespread arrhythmic involuntary movements of a forcible, jerky and restless fashion. It is a random-appearing sequence of one or more discrete involuntary movements or movement fragments. Movements appear random because of variability in timing, duration or location. Each movement may have a distinct start and end. However, movements may be strung together and thus may appear to flow randomly from one muscle group to another. Chorea can involve the trunk, neck, face, tongue, and extremities. Evidence: TAS. Frequency: Occasional (HP:0040283). (ORPHA:94093)
- Hyperuricemia (HP:0002149): The concentration of uric acid in the blood circulation is above the upper limit of normal. Evidence: TAS. Frequency: Occasional (HP:0040283). (ORPHA:94093)
- Hyperkalemia (HP:0002153): The concentration of potassium(1+) in the blood circulation is above the upper limit of normal. Evidence: TAS. Frequency: Occasional (HP:0040283). (ORPHA:94093)
- Pulmonary embolism (HP:0002204): An embolus (that is, an abnormal particle circulating in the blood) located in the pulmonary artery and thereby blocking blood circulation to the lung. Usually the embolus is a blood clot that has developed in an extremity (for instance, a deep venous thrombosis), detached, and traveled through the circulation before becoming trapped in the pulmonary artery. Evidence: TAS. Frequency: Occasional (HP:0040283). (ORPHA:94093)
- Hypotension (HP:0002615): Low Blood Pressure, vascular hypotension. Evidence: TAS. Frequency: Occasional (HP:0040283). (ORPHA:94093)
- Hypocalcemia (HP:0002901): The concentration of calcium in the blood circulation is below the lower limit of normal. Evidence: TAS. Frequency: Occasional (HP:0040283). (ORPHA:94093)
- Hyponatremia (HP:0002902): The concentration of sodium in the blood circulation is below the lower limit of normal. Evidence: TAS. Frequency: Occasional (HP:0040283). (ORPHA:94093)
- Hyperphosphatemia (HP:0002905): The concentration of phosphate ion in the blood circulation is above the upper limit of normal. Evidence: TAS. Frequency: Occasional (HP:0040283). (ORPHA:94093)
- Elevated circulating hepatic transaminase concentration (HP:0002910): Elevations of the levels of SGOT and SGPT in the serum. SGOT (serum glutamic oxaloacetic transaminase) and SGPT (serum glutamic pyruvic transaminase) are transaminases primarily found in the liver and heart and are released into the bloodstream as the result of liver or heart damage. SGOT and SGPT are used clinically mainly as markers of liver damage. Evidence: TAS. Frequency: Occasional (HP:0040283). (ORPHA:94093)
- Myoglobinuria (HP:0002913): Presence of myoglobin in the urine. Evidence: TAS. Frequency: Occasional (HP:0040283). (ORPHA:94093)
- Hypomagnesemia (HP:0002917): The concentration of magnesium in the blood circulation is below the lower limit of normal. Evidence: TAS. Frequency: Occasional (HP:0040283). (ORPHA:94093)
- Elevated circulating alkaline phosphatase concentration (HP:0003155): Abnormally increased serum levels of alkaline phosphatase activity. Evidence: TAS. Frequency: Occasional (HP:0040283). (ORPHA:94093)
- Rhabdomyolysis (HP:0003201): Breakdown of muscle fibers that leads to the release of muscle fiber contents (myoglobin) into the bloodstream. Evidence: TAS. Frequency: Occasional (HP:0040283). (ORPHA:94093)
- Hypernatremia (HP:0003228): The concentration of sodium in the blood circulation is above the upper limit of normal. Evidence: TAS. Frequency: Occasional (HP:0040283). (ORPHA:94093)
- Oculogyric crisis (HP:0010553): An acute dystonic reaction with blepharospasm, periorbital twitches, and protracted fixed staring episodes. There may be a maximal upward deviation of the eyes in the sustained fashion. Oculogyric crisis can be triggered by a number of factors including neuroleptic medications. Evidence: TAS. Frequency: Occasional (HP:0040283). (ORPHA:94093)
- Arrhythmia (HP:0011675): Any cardiac rhythm other than the normal sinus rhythm. Such a rhythm may be either of sinus or ectopic origin and either regular or irregular. An arrhythmia may be due to a disturbance in impulse formation or conduction or both. Evidence: TAS. Frequency: Occasional (HP:0040283). (ORPHA:94093)
- Aspiration pneumonia (HP:0011951): Pneumonia due to the aspiration (breathing in) of food, liquid, or gastric contents into the upper respiratory tract. Evidence: TAS. Frequency: Occasional (HP:0040283). (ORPHA:94093)
- Rigors (HP:0025145): Severe chills with violent shivering. A rigor is an episode of shaking or exaggerated shivering which can occur with a high fever. Evidence: TAS. Frequency: Occasional (HP:0040283). (ORPHA:94093)
- Increased circulating lactate dehydrogenase concentration (HP:0025435): An elevated level of the enzyme lactate dehydrogenase in the blood circulation. Evidence: TAS. Frequency: Occasional (HP:0040283). (ORPHA:94093)
- Delirium (HP:0031258): A state of sudden and severe confusion. Evidence: TAS. Frequency: Occasional (HP:0040283). (ORPHA:94093)
- Nasogastric tube feeding (HP:0040288): The condition of inability to eat normally treated by placement of a thin tube through the nose into the stomach that is then used to carry food. Evidence: TAS. Frequency: Occasional (HP:0040283). (ORPHA:94093)
- Hypertensive crisis (HP:0100735). Evidence: TAS. Frequency: Occasional (HP:0040283). (ORPHA:94093)
- Bradycardia (HP:0001662): A slower than normal heart rate (in adults, slower than 60 beats per minute). Evidence: TAS. Frequency: Very rare (HP:0040284). (ORPHA:94093)
- Thrombocytopenia (HP:0001873): A reduction in the number of circulating thrombocytes. Evidence: TAS. Frequency: Very rare (HP:0040284). (ORPHA:94093)
- Hypothermia (HP:0002045): Reduced body temperature due to failed thermoregulation. Evidence: TAS. Frequency: Very rare (HP:0040284). (ORPHA:94093)
- Sepsis (HP:0100806): Sepsis is defined as life-threatening organ dysfunction caused by a dysregulated host response to infection. Evidence: TAS. Frequency: Very rare (HP:0040284). (ORPHA:94093)